Phenotypes associated with the disease autosomal recessive nonsyndromic hearing loss 76 (OMIM:615540):
- Congenital onset (HP:0003577): A phenotypic abnormality that is present at birth. Evidence: PCS. (PMID:23348741)
- Progressive sensorineural hearing impairment (HP:0000408): A progressive form of sensorineural hearing impairment. Evidence: PCS. Frequency: 6/6. (PMID:23348741)
- Childhood onset (HP:0011463): Onset of disease at the age of between 1 and 5 years. Evidence: PCS. (PMID:23348741)
- Infantile onset (HP:0003593): Onset of signs or symptoms of disease between 28 days to one year of life. Evidence: PCS. (PMID:23348741)
- Autosomal recessive inheritance (HP:0000007): A mode of inheritance that is observed for traits related to a gene encoded on one of the autosomes (i.e., the human chromosomes 1-22) in which a trait manifests in individuals with two pathogenic alleles, either homozygotes (two copies of the same mutant allele) or compound heterozygotes (whereby each copy of a gene has a distinct mutant allele). Evidence: PCS. (PMID:23348741)